Phenotypes associated with the disease dysmorphism-conductive hearing loss-heart defect syndrome (OMIM:615102):
- Narrow palate (HP:0000189): Width of the palate more than 2 SD below the mean (objective) or apparently decreased palatal width (subjective). Evidence: TAS. (OMIM:615102)
- Mild intellectual disability (HP:0001256): Mild intellectual disability (ID) is defined as a type of ID characterized by mildly sub-average adaptive functioning and intellectual functioning, with an intelligence quotient (IQ) the range of 50-69. Evidence: TAS. (OMIM:615102)
- Short stature (HP:0004322): A height below that which is expected according to age and gender norms. Although there is no universally accepted definition of short stature, many refer to "short stature" as height more than 2 standard deviations below the mean for age and gender (or below the 3rd percentile for age and gender dependent norms). Evidence: TAS. (OMIM:615102)
- Ventricular septal defect (HP:0001629): A hole between the two bottom chambers (ventricles) of the heart. The defect is centered around the most superior aspect of the ventricular septum. Evidence: TAS. (OMIM:615102)
- High palate (HP:0000218): Height of the palate more than 2 SD above the mean (objective) or palatal height at the level of the first permanent molar more than twice the height of the teeth (subjective). Evidence: TAS. (OMIM:615102)
- Narrow chest (HP:0000774): Reduced width of the chest from side to side, associated with a reduced distance from the sternal notch to the tip of the shoulder. Evidence: TAS. (OMIM:615102)
- Pulmonic stenosis (HP:0001642): A narrowing of the right ventricular outflow tract that can occur at the pulmonary valve (valvular stenosis), below the pulmonary valve (infundibular stenosis), or above the pulmonary valve (supravalvar stenosis). Evidence: TAS. (OMIM:615102)
- Supernumerary nipple (HP:0002558): Presence of more than two nipples. Evidence: TAS. (OMIM:615102)
- Posteriorly rotated ears (HP:0000358): A type of abnormal location of the ears in which the position of the ears is characterized by posterior rotation (the superior part of the ears is rotated towards the back of the head, and the inferior part of the ears towards the front). Evidence: TAS. (OMIM:615102)
- Premature birth (HP:0001622): The birth of a baby of less than 37 weeks of gestational age. Evidence: TAS. (OMIM:615102)
- Cleft palate (HP:0000175): Cleft palate is a developmental defect of the palate resulting from a failure of fusion of the palatine processes and manifesting as a separation of the roof of the mouth (soft and hard palate). Evidence: TAS. (OMIM:615102)
- Polyhydramnios (HP:0001561): The presence of excess amniotic fluid in the uterus during pregnancy. Evidence: TAS. (OMIM:615102)
- Short chin (HP:0000331): Decreased vertical distance from the vermilion border of the lower lip to the inferior-most point of the chin. Evidence: TAS. (OMIM:615102)
- Hypoplasia of the corpus callosum (HP:0002079): Underdevelopment of the corpus callosum. Evidence: TAS. (OMIM:615102)
- Feeding difficulties (HP:0011968): Impaired ability to eat related to problems gathering food and getting ready to suck, chew, or swallow it. Evidence: TAS. (OMIM:615102)
- Global developmental delay (HP:0001263): A delay in the achievement of motor or mental milestones in the domains of development of a child, including motor skills, speech and language, cognitive skills, and social and emotional skills. This term should only be used to describe children younger than five years of age. Evidence: TAS. (OMIM:615102)
- Low anterior hairline (HP:0000294): Distance between the hairline (trichion) and the glabella (the most prominent point on the frontal bone above the root of the nose), in the midline, more than two SD below the mean. Alternatively, an apparently decreased distance between the hairline and the glabella. Evidence: TAS. (OMIM:615102)
- Sleep apnea (HP:0010535): An intermittent cessation of airflow at the mouth and nose during sleep is known as sleep apnea. Apneas that last at least 10 seconds are considered significant, but individuals with sleep apnea may experience apneas lasting from 20 seconds up to 2 or 3 minutes. Patients may have up to 15 events per hour of sleep. Evidence: TAS. (OMIM:615102)
- Thick hair (HP:0100874): Increased density of hairs, i.e., and elevated number of hairs per unit area. Evidence: TAS. (OMIM:615102)
- Ptosis (HP:0000508): The upper eyelid margin is positioned 3 mm or more lower than usual and covers the superior portion of the iris (objective); or, the upper lid margin obscures at least part of the pupil (subjective). Evidence: TAS. (OMIM:615102)
- Pectus excavatum (HP:0000767): A defect of the chest wall characterized by a depression of the sternum, giving the chest ("pectus") a caved-in ("excavatum") appearance. Evidence: TAS. (OMIM:615102)
- High, narrow palate (HP:0002705): The presence of a high and narrow palate. Evidence: TAS. (OMIM:615102)
- Intrauterine growth retardation (HP:0001511): An abnormal restriction of fetal growth with fetal weight below the tenth percentile for gestational age. Evidence: TAS. (OMIM:615102)
- Atrial septal defect (HP:0001631): Atrial septal defect (ASD) is a congenital abnormality of the interatrial septum that enables blood flow between the left and right atria via the interatrial septum. Evidence: TAS. (OMIM:615102)
- Proptosis (HP:0000520): An eye that is protruding anterior to the plane of the face to a greater extent than is typical. Evidence: TAS. (OMIM:615102)
- Cryptorchidism (HP:0000028): Testis in inguinal canal. That is, absence of one or both testes from the scrotum owing to failure of the testis or testes to descend through the inguinal canal to the scrotum. Evidence: TAS. (OMIM:615102)
- Low-set ears (HP:0000369): Upper insertion of the ear to the scalp below an imaginary horizontal line drawn between the inner canthi of the eye and extending posteriorly to the ear. Evidence: TAS. (OMIM:615102)
- Autosomal dominant inheritance (HP:0000006): A mode of inheritance that is observed for traits related to a gene encoded on one of the autosomes (i.e., the human chromosomes 1-22) in which a trait manifests in heterozygotes. In the context of medical genetics, an autosomal dominant disorder is caused when a single copy of the mutant allele is present. Males and females are affected equally, and can both transmit the disorder with a risk of 50% for each child of inheriting the mutant allele. Evidence: TAS. (OMIM:615102)